Phenotypes associated with the disease ventricular tachycardia, familial (OMIM:192605):
- Paroxysmal ventricular tachycardia (HP:0004751): Episodes of ventricular tachycardia that have a sudden onset and ending. Evidence: PCS. Frequency: 1/1. (PMID:9637720)
- Typified by somatic mosaicism (HP:0001442): Description of conditions in which affected individuals typically display somatic mosaicism, i.e., genetically distinct populations of somatic cells in a given organism caused by DNA mutations, epigenetic alterations of DNA, chromosomal abnormalities or the spontaneous reversion of inherited mutations. In many conditions typified by somatic mosaicism, constitutive mutation is lethal and cases are exclusively or predominantly mosaic. Evidence: PCS. (PMID:9637720)
- Adult onset (HP:0003581): Onset of disease manifestations in adulthood, defined here as at the age of 16 years or later. Evidence: PCS. Frequency: 1/1. (PMID:9637720)
- Complete right bundle branch block (HP:0011712): A conduction block of the right branch of the bundle of His. This manifests as a prolongation of the QRS complex (greater than 0.12 s) with delayed activation of the right ventricle and terminal delay on the EKG. Evidence: IEA. (OMIM:192605)
- Cardiomyopathy (HP:0001638): A myocardial disorder in which the heart muscle is structurally and functionally abnormal, in the absence of coronary artery disease, hypertension, valvular disease and congenital heart disease sufficient to cause the observed myocardial abnormality. Evidence: PCS. Frequency: 0/1. (PMID:9637720)
- Autosomal dominant inheritance (HP:0000006): A mode of inheritance that is observed for traits related to a gene encoded on one of the autosomes (i.e., the human chromosomes 1-22) in which a trait manifests in heterozygotes. In the context of medical genetics, an autosomal dominant disorder is caused when a single copy of the mutant allele is present. Males and females are affected equally, and can both transmit the disorder with a risk of 50% for each child of inheriting the mutant allele. Evidence: PCS. (PMID:9637720)
- Sudden cardiac death (HP:0001645): The heart suddenly and unexpectedly stops beating resulting in death within a short time period (generally within 1 h of symptom onset). Evidence: IEA. (OMIM:192605)